- Spicular pigmentation of the retina (HP:0007737): Pigment migration into the retina in a bone-spicule configuration (resembling the nucleated cells within the lacuna of bone). Evidence: PCS. (PMID:19878916)
- Nyctalopia (HP:0000662): Inability to see well at night or in poor light. Evidence: PCS. (PMID:19878916)
- Visual impairment (HP:0000505): Visual impairment (or vision impairment) is vision loss (of a person) to such a degree as to qualify as an additional support need through a significant limitation of visual capability resulting from either disease, trauma, or congenital or degenerative conditions that cannot be corrected by conventional means, such as refractive correction, medication, or surgery. Evidence: PCS. (PMID:19878916)
- Optic disc pallor (HP:0000543): A pale yellow discoloration of the optic disc (the area of the optic nerve head in the retina). The optic disc normally has a pinkish hue with a central yellowish depression. Evidence: PCS. (PMID:19878916)
- Rod-cone dystrophy (HP:0000510): An inherited retinal disease subtype in which the rod photoreceptors appear to be more severely affected than the cone photoreceptors. Typical presentation is with nyctalopia (due to rod dysfunction) followed by loss of mid-peripheral field of vision, which gradually extends and leaves many patients with a small central island of vision due to the preservation of macular cones. Evidence: IEA. (OMIM:610359)
- Attenuation of retinal blood vessels (HP:0007843): Narrowing of the retinal blood vessels, both arterioles and venules. Evidence: PCS. (PMID:19878916)
- Retinal pigment epithelial atrophy (HP:0007722): A nonspecific term denoting wasting, especially as a result of degeneration, of the retinal pigment epithelium (RPE). Evidence: PCS. (PMID:19878916)
- Autosomal dominant inheritance (HP:0000006): A mode of inheritance that is observed for traits related to a gene encoded on one of the autosomes (i.e., the human chromosomes 1-22) in which a trait manifests in heterozygotes. In the context of medical genetics, an autosomal dominant disorder is caused when a single copy of the mutant allele is present. Males and females are affected equally, and can both transmit the disorder with a risk of 50% for each child of inheriting the mutant allele. Evidence: PCS. (PMID:19878916)
These phenotypes are associated with the disease retinitis pigmentosa 33 (OMIM:610359).